- Premature ovarian insufficiency (HP:0008209): Amenorrhea due to loss of ovarian function before the age of 40. Primary ovarian insuficiency (POI) is a state of female hypergonadotropic hypogonadism. It can manifest as primary amenorrhea with onset before menarche or secondary amenorrhea. Evidence: PCS. Frequency: 1/1. Onset: Young adult onset (HP:0011462). (PMID:35587281)
- Premature ovarian insufficiency (HP:0008209): Amenorrhea due to loss of ovarian function before the age of 40. Primary ovarian insuficiency (POI) is a state of female hypergonadotropic hypogonadism. It can manifest as primary amenorrhea with onset before menarche or secondary amenorrhea. Evidence: PCS. Frequency: 2/2. (PMID:35708642)
- Early young adult onset (HP:0025708): Onset of disease at an age of greater than or equal to 16 to under 19 years. Evidence: PCS. Frequency: 1/1. (PMID:35587281)
- Secondary amenorrhea (HP:0000869). Evidence: PCS. Frequency: 2/2. Onset: Intermediate young adult onset (HP:0025709). (PMID:35708642)
- Female infertility (HP:0008222). Evidence: PCS. Frequency: 1/1. (PMID:35587281)
- Young adult onset (HP:0011462): Onset of disease at the age of between 16 and 40 years. Evidence: PCS. Frequency: 2/2. (PMID:35708642)
- Elevated circulating follicle stimulating hormone level (HP:0008232): An elevated concentration of follicle-stimulating hormone in the blood. Evidence: PCS. Frequency: 2/2. (PMID:35708642)
- Autosomal recessive inheritance (HP:0000007): A mode of inheritance that is observed for traits related to a gene encoded on one of the autosomes (i.e., the human chromosomes 1-22) in which a trait manifests in individuals with two pathogenic alleles, either homozygotes (two copies of the same mutant allele) or compound heterozygotes (whereby each copy of a gene has a distinct mutant allele). Evidence: PCS. (PMID:35587281)
- Decreased circulating antimullerian hormone circulation (HP:0031103): A reduction below the normal range of the antimullerian hormone in the circulation. Evidence: PCS. Frequency: 2/2. (PMID:35708642)
These phenotypes are associated with the disease premature ovarian failure 22 (OMIM:620548).